- Short stature (HP:0004322): A height below that which is expected according to age and gender norms. Although there is no universally accepted definition of short stature, many refer to "short stature" as height more than 2 standard deviations below the mean for age and gender (or below the 3rd percentile for age and gender dependent norms). Evidence: TAS. Frequency: Frequent (HP:0040282). (ORPHA:1201)
- Jejunal atresia (HP:0005235): A developmental defect resulting in abnormal closure, or atresia of the tubular structure of the jejunum. Evidence: TAS. Frequency: Frequent (HP:0040282). (ORPHA:1201)
- Feeding difficulties (HP:0011968): Impaired ability to eat related to problems gathering food and getting ready to suck, chew, or swallow it. Evidence: TAS. Frequency: Frequent (HP:0040282). (ORPHA:1201)
- Abnormal vascular morphology (HP:0025015). Evidence: TAS. Frequency: Frequent (HP:0040282). (ORPHA:1201)
- Intestinal hypoplasia (HP:0005245): Developmental hypoplasia of the intestine. Evidence: TAS. Frequency: Very frequent (HP:0040281). (ORPHA:1201)
- Failure to thrive (HP:0001508): Failure to thrive (FTT) refers to a child whose physical growth is substantially below the norm. Evidence: TAS. Frequency: Frequent (HP:0040282). (ORPHA:1201)
- Intrauterine growth retardation (HP:0001511): An abnormal restriction of fetal growth with fetal weight below the tenth percentile for gestational age. Evidence: TAS. Frequency: Frequent (HP:0040282). (ORPHA:1201)
- Vomiting (HP:0002013): Forceful ejection of the contents of the stomach through the mouth by means of a series of involuntary spasmic contractions. Evidence: TAS. Frequency: Frequent (HP:0040282). (ORPHA:1201)
- Intestinal malrotation (HP:0002566): An abnormality of the intestinal rotation and fixation that normally occurs during the development of the gut. This can lead to volvulus, or twisting of the intestine that causes obstruction and necrosis. Evidence: TAS. Frequency: Frequent (HP:0040282). (ORPHA:1201)
- Abdominal distention (HP:0003270): Distention of the abdomen. Evidence: TAS. Frequency: Frequent (HP:0040282). (ORPHA:1201)
These phenotypes are associated with the disease Small bowel atresia (ORPHA:1201).